Phenotypes associated with the disease myopia 26, X-linked, female-limited (OMIM:301010):
- X-linked inheritance (HP:0001417): A mode of inheritance that is observed for traits related to a gene encoded on the X chromosome. Evidence: PCS. (PMID:27829781)
- High myopia (HP:0011003): A severe form of myopia with greater than -6.00 diopters. Evidence: PCS. Frequency: 15/15. Onset: Childhood onset (HP:0011463). (PMID:27829781)